- Hypertonia (HP:0001276): A condition in which there is increased muscle tone so that arms or legs, for example, are stiff and difficult to move. Evidence: PCS. Frequency: 1/4. (PMID:27799064)
- Wide mouth (HP:0000154): Distance between the oral commissures more than 2 SD above the mean. Alternatively, an apparently increased width of the oral aperture (subjective). Evidence: PCS. Frequency: 1/4. (PMID:27799064)
- Microcephaly (HP:0000252): Head circumference below 2 standard deviations below the mean for age and gender. Evidence: PCS. Frequency: 2/4. (PMID:27799064)
- Anteverted nares (HP:0000463): Anteriorly-facing nostrils viewed with the head in the Frankfurt horizontal and the eyes of the observer level with the eyes of the subject. This gives the appearance of an upturned nose (upturned nasal tip). Evidence: PCS. Frequency: 1/4. (PMID:27799064)
- Feeding difficulties (HP:0011968): Impaired ability to eat related to problems gathering food and getting ready to suck, chew, or swallow it. Evidence: PCS. Frequency: 2/4. (PMID:27799064)
- Seizure (HP:0001250): A seizure is an intermittent abnormality of nervous system physiology characterized by a transient occurrence of signs and/or symptoms due to abnormal excessive or synchronous neuronal activity in the brain. Evidence: PCS. Frequency: 3/4. (PMID:27799064)
- Deeply set eye (HP:0000490): An eye that is more deeply recessed into the plane of the face than is typical. Evidence: PCS. Frequency: 1/4. (PMID:27799064)
- Global developmental delay (HP:0001263): A delay in the achievement of motor or mental milestones in the domains of development of a child, including motor skills, speech and language, cognitive skills, and social and emotional skills. This term should only be used to describe children younger than five years of age. Evidence: PCS. Frequency: 4/4. (PMID:27799064)
- Increased circulating lactate concentration (HP:0002151): Abnormally increased level of blood lactate (2-hydroxypropanoic acid). Lactate is produced from pyruvate by lactate dehydrogenase during normal metabolism. The terms lactate and lactic acid are often used interchangeably but lactate (the component measured in blood) is strictly a weak base whereas lactic acid is the corresponding acid. Lactic acidosis is often used clinically to describe elevated lactate but should be reserved for cases where there is a corresponding acidosis (pH below 7.35). Evidence: PCS. Frequency: 4/4. (PMID:27799064)
- Hypotonia (HP:0001252): Hypotonia is an abnormally low muscle tone (the amount of tension or resistance to movement in a muscle). Even when relaxed, muscles have a continuous and passive partial contraction which provides some resistance to passive stretching. Hypotonia thus manifests as diminished resistance to passive stretching. Hypotonia is not the same as muscle weakness, although the two conditions can co-exist. Evidence: PCS. Frequency: 4/4. (PMID:27799064)
- Infantile onset (HP:0003593): Onset of signs or symptoms of disease between 28 days to one year of life. Evidence: PCS. Frequency: 4/4. (PMID:27799064)
- Left ventricular noncompaction (HP:0030682): Left ventricular noncompaction (LVNC) is defined by 3 markers: prominent left ventricular (LV) trabeculae, deep intertrabecular recesses, and the thin compacted layer. Evidence: PCS. Frequency: 4/4. (PMID:27799064)
- Midface retrusion (HP:0011800): Posterior positions and/or vertical shortening of the infraorbital and perialar regions, or increased concavity of the face and/or reduced nasolabial angle. Evidence: PCS. Frequency: 1/4. (PMID:27799064)
- Depressed nasal bridge (HP:0005280): Posterior positioning of the nasal root in relation to the overall facial profile for age. Evidence: PCS. Frequency: 1/4. (PMID:27799064)
- Cataract (HP:0000518): A cataract is an opacity or clouding that develops in the crystalline lens of the eye or in its capsule. Evidence: PCS. Frequency: 1/3. (PMID:27799064)
- Failure to thrive (HP:0001508): Failure to thrive (FTT) refers to a child whose physical growth is substantially below the norm. Evidence: PCS. Frequency: 4/4. (PMID:27799064)
- Hypertrophic cardiomyopathy (HP:0001639): Hypertrophic cardiomyopathy (HCM) is defined by the presence of increased ventricular wall thickness or mass in the absence of loading conditions (hypertension, valve disease) sufficient to cause the observed abnormality. Evidence: PCS. Frequency: 4/4. (PMID:27799064)
- Increased intramyocellular lipid droplets (HP:0012240): An abnormal increase in intracellular lipid droplets In a muscle. The number and size of these drops can increase with somd disorders of lipid metabolism affecting muscle. See PMID 20691590 for histological images. Evidence: PCS. Frequency: 3/3. (PMID:27799064)
- Autosomal recessive inheritance (HP:0000007): A mode of inheritance that is observed for traits related to a gene encoded on one of the autosomes (i.e., the human chromosomes 1-22) in which a trait manifests in individuals with two pathogenic alleles, either homozygotes (two copies of the same mutant allele) or compound heterozygotes (whereby each copy of a gene has a distinct mutant allele). Evidence: PCS. (PMID:27799064)
- Bulbous nose (HP:0000414): Increased volume and globular shape of the anteroinferior aspect of the nose. Evidence: PCS. Frequency: 1/4. (PMID:27799064)
- Micrognathia (HP:0000347): Developmental hypoplasia of the mandible. Evidence: PCS. Frequency: 1/4. (PMID:27799064)
- Hyperalaninemia (HP:0003348): An increased concentration of alanine in the blood. Evidence: PCS. Frequency: 4/4. (PMID:27799064)
- Lactic acidosis (HP:0003128): An abnormal buildup of lactic acid in the body, leading to acidification of the blood and other bodily fluids. Evidence: PCS. Frequency: 4/4. (PMID:27799064)
- Increased variability in muscle fiber diameter (HP:0003557): An abnormally high degree of muscle fiber size variation. This phenotypic feature can be observed upon muscle biopsy. Evidence: PCS. Frequency: 2/3. (PMID:27799064)
These phenotypes are associated with the disease lethal left ventricular non-compaction-seizures-hypotonia-cataract-developmental delay syndrome (OMIM:617228).